- Central diabetes insipidus (HP:0000863): A form of diabetes insipidus related to a failure of vasopressin (AVP) release from the hypothalamus. Evidence: TAS. Frequency: Very frequent (HP:0040281). (ORPHA:95513)
- Panhypopituitarism (HP:0000871): A pituitary functional deficit affecting all the anterior pituitary hormones (growth hormone, thyroid-stimulating hormone, follicle-stimulating hormone, luteinizing hormone, adrenocorticotropic hormone, and prolactin). Evidence: TAS. Frequency: Very frequent (HP:0040281). (ORPHA:95513)
- Abnormal posterior pituitary morphogenesis (HP:0011751): An abnormality of the neurohypophysis, which is also known as the posterior lobe of the hypophysis. Evidence: TAS. Frequency: Very frequent (HP:0040281). (ORPHA:95513)
- Amenorrhea (HP:0000141): Absence of menses for an interval of time equivalent to a total of more than (or equal to) 3 previous cycles or 6 months. Evidence: TAS. Frequency: Frequent (HP:0040282). (ORPHA:95513)
- Blurred vision (HP:0000622): Lack of sharpness of vision resulting in the inability to see fine detail. Evidence: TAS. Frequency: Frequent (HP:0040282). (ORPHA:95513)
- Impotence (HP:0000802): Inability to develop or maintain an erection of the penis. Evidence: TAS. Frequency: Frequent (HP:0040282). (ORPHA:95513)
- Increased circulating prolactin concentration (HP:0000870): The presence of abnormally increased levels of prolactin in the blood. Prolactin is a peptide hormone produced by the anterior pituitary gland that plays a role in breast development and lactation during pregnancy. Evidence: TAS. Frequency: Frequent (HP:0040282). (ORPHA:95513)
- Pallor (HP:0000980): Abnormally pale skin. Evidence: TAS. Frequency: Frequent (HP:0040282). (ORPHA:95513)
- Orthostatic hypotension (HP:0001278): A form of hypotension characterized by a sudden fall in blood pressure that occurs when a person assumes a standing position. Evidence: TAS. Frequency: Frequent (HP:0040282). (ORPHA:95513)
- Normochromic anemia (HP:0001895). Evidence: TAS. Frequency: Frequent (HP:0040282). (ORPHA:95513)
- Polydipsia (HP:0001959): Excessive thirst manifested by excessive fluid intake. Evidence: TAS. Frequency: Frequent (HP:0040282). (ORPHA:95513)
- Nausea (HP:0002018): A sensation of unease in the stomach together with an urge to vomit. Evidence: TAS. Frequency: Frequent (HP:0040282). (ORPHA:95513)
- Headache (HP:0002315): Cephalgia, or pain sensed in various parts of the head, not confined to the area of distribution of any nerve. Evidence: TAS. Frequency: Frequent (HP:0040282). (ORPHA:95513)
- Hyposthenuria (HP:0003158): An abnormally low urinary specific gravity, i.e., reduced concentration of solutes in the urine. Evidence: TAS. Frequency: Frequent (HP:0040282). (ORPHA:95513)
- Progressive visual field defects (HP:0007987). Evidence: TAS. Frequency: Frequent (HP:0040282). (ORPHA:95513)
- Decreased circulating cortisol level (HP:0008163): Abnormally reduced concentration of cortisol in the blood. Evidence: TAS. Frequency: Frequent (HP:0040282). (ORPHA:95513)
- Gonadotropin deficiency (HP:0008213): A reduced ability to secrete gonadotropins, which are protein hormones secreted by gonadotrope cells of the anterior pituitary gland, including the hormones follitropin (FSH) and luteinizing hormone (LH). Evidence: TAS. Frequency: Frequent (HP:0040282). (ORPHA:95513)
- Decreased serum estradiol (HP:0008214): A reduction below normal concentration of estradiol in the circulation. Evidence: TAS. Frequency: Frequent (HP:0040282). (ORPHA:95513)
- Secondary growth hormone deficiency (HP:0008240). Evidence: TAS. Frequency: Frequent (HP:0040282). (ORPHA:95513)
- Pituitary hypothyroidism (HP:0008245): A type of hypothyroidism that results from a defect in thyroid-stimulating hormone secretion. Evidence: TAS. Frequency: Frequent (HP:0040282). (ORPHA:95513)
- Adrenocorticotropin deficient adrenal insufficiency (HP:0011735): Adrenal insufficiency secondary to a defect in ACTH production. Evidence: TAS. Frequency: Frequent (HP:0040282). (ORPHA:95513)
- Adrenocorticotropic hormone deficiency (HP:0011748): A reduced ability to secrete adrenocorticotropic hormone (ACTH), a hormone that stimulates the adrenal cortex to secrete of glucocorticoids such as cortisol. Evidence: TAS. Frequency: Frequent (HP:0040282). (ORPHA:95513)
- Abnormal size of pituitary gland (HP:0012504): A deviation from the normal size of the pituitary gland. Evidence: TAS. Frequency: Frequent (HP:0040282). (ORPHA:95513)
- Abnormal thalamic MRI signal intensity (HP:0012696): A deviation from normal signal on magnetic resonance imaging (MRI) of the thalamus. Evidence: TAS. Frequency: Frequent (HP:0040282). (ORPHA:95513)
- Decreased female libido (HP:0030018): Diminished sexual desire in female. Evidence: TAS. Frequency: Frequent (HP:0040282). (ORPHA:95513)
- Decreased serum testosterone concentration (HP:0040171). Evidence: TAS. Frequency: Frequent (HP:0040282). (ORPHA:95513)
- Decreased male libido (HP:0040306): Reduced desire for sexual activity on the part of a male. Evidence: TAS. Frequency: Frequent (HP:0040282). (ORPHA:95513)
- Sensorineural hearing impairment (HP:0000407): A type of hearing impairment in one or both ears related to an abnormal functionality of the cochlear nerve. Evidence: TAS. Frequency: Occasional (HP:0040283). (ORPHA:95513)
- Diplopia (HP:0000651): Diplopia is a condition in which a single object is perceived as two images, it is also known as double vision. Evidence: TAS. Frequency: Occasional (HP:0040283). (ORPHA:95513)
- Hashimoto thyroiditis (HP:0000872): A chronic, autoimmune type of thyroiditis associated with hypothyroidism. Evidence: TAS. Frequency: Occasional (HP:0040283). (ORPHA:95513)
- Hyponatremia (HP:0002902): The concentration of sodium in the blood circulation is below the lower limit of normal. Evidence: TAS. Frequency: Occasional (HP:0040283). (ORPHA:95513)
- Antinuclear antibody positivity (HP:0003493): The presence of autoantibodies in the serum that react against nuclei or nuclear components. Evidence: TAS. Frequency: Occasional (HP:0040283). (ORPHA:95513)
- Poor appetite (HP:0004396): A reduced desire to eat. Evidence: TAS. Frequency: Occasional (HP:0040283). (ORPHA:95513)
- Chronic lymphocytic meningitis (HP:0007041): Meningitis that persists for more than 4 weeks, and lymphocytes are present in the cerebrospinal fluid (CSF). Evidence: TAS. Frequency: Occasional (HP:0040283). (ORPHA:95513)
- Reduced circulating prolactin concentration (HP:0008202): A reduced level of prolactin in the blood circulation. Prolactin is a protein hormone that is secreted by lactotrophs in the anterior pituitary and that stimulates mammary gland development and milk production. Evidence: TAS. Frequency: Occasional (HP:0040283). (ORPHA:95513)
These phenotypes are associated with the disease Panhypophysitis (ORPHA:95513).